- Typified by somatic mosaicism (HP:0001442): Description of conditions in which affected individuals typically display somatic mosaicism, i.e., genetically distinct populations of somatic cells in a given organism caused by DNA mutations, epigenetic alterations of DNA, chromosomal abnormalities or the spontaneous reversion of inherited mutations. In many conditions typified by somatic mosaicism, constitutive mutation is lethal and cases are exclusively or predominantly mosaic. Evidence: TAS. (OMIM:608089)
- Endometrial carcinoma (HP:0012114): A carcinoma of the endometrium, the mucous lining of the uterus. Evidence: TAS. (OMIM:608089)
- Autosomal dominant inheritance (HP:0000006): A mode of inheritance that is observed for traits related to a gene encoded on one of the autosomes (i.e., the human chromosomes 1-22) in which a trait manifests in heterozygotes. In the context of medical genetics, an autosomal dominant disorder is caused when a single copy of the mutant allele is present. Males and females are affected equally, and can both transmit the disorder with a risk of 50% for each child of inheriting the mutant allele. Evidence: TAS. (OMIM:608089)
These phenotypes are associated with the disease endometrial cancer (OMIM:608089).